- Secundum atrial septal defect (HP:0001684): A kind of atrial septum defect arising from an enlarged foramen ovale, inadequate growth of the septum secundum, or excessive absorption of the septum primum. Evidence: TAS. (OMIM:212090)
- Perimembranous ventricular septal defect (HP:0011682): A ventricular septal defect that is confluent with and involves the membranous septum and is bordered by an atrioventricular valve, not including the type 3 VSDs. Evidence: TAS. (OMIM:212090)
- Coarctation of aorta (HP:0001680): Coarctation of the aorta is a narrowing or constriction of a segment of the aorta. Evidence: TAS. (OMIM:212090)
- Autosomal recessive inheritance (HP:0000007): A mode of inheritance that is observed for traits related to a gene encoded on one of the autosomes (i.e., the human chromosomes 1-22) in which a trait manifests in individuals with two pathogenic alleles, either homozygotes (two copies of the same mutant allele) or compound heterozygotes (whereby each copy of a gene has a distinct mutant allele). Evidence: TAS. (OMIM:212090)
These phenotypes are associated with the disease cardiac septal defects with coarctation of the aorta (OMIM:212090).